Phenotypes associated with the disease spermatogenic failure 27 (OMIM:617965):
- Coiled sperm flagella (HP:0032560): Sperm cells whose flagella are twisted (coiled). Evidence: PCS. Frequency: 2/2. (PMID:29365104)
- Male infertility (HP:0003251). Evidence: PCS. Frequency: 2/2. (PMID:29365104)
- Young adult onset (HP:0011462): Onset of disease at the age of between 16 and 40 years. Evidence: PCS. Frequency: 2/2. (PMID:29365104)
- Autosomal recessive inheritance (HP:0000007): A mode of inheritance that is observed for traits related to a gene encoded on one of the autosomes (i.e., the human chromosomes 1-22) in which a trait manifests in individuals with two pathogenic alleles, either homozygotes (two copies of the same mutant allele) or compound heterozygotes (whereby each copy of a gene has a distinct mutant allele). Evidence: PCS. (PMID:29365104)
- Reduced sperm motility (HP:0012207): An abnormal reduction in the mobility of ejaculated sperm. Evidence: PCS. Frequency: 2/2. (PMID:29365104)
- Absent sperm axoneme central pair complex (HP:0033525): Absence of the central pair of microtubules in the sperm axoneme, thereby forming a 9+0 pattern instead of the normal 9+2 pattern. Evidence: PCS. Frequency: 1/1. (PMID:29365104)
- Absent sperm flagella (HP:0032558): Sperm cells lacking flagella. Evidence: PCS. Frequency: 2/2. (PMID:29365104)
- Short sperm flagella (HP:0032559): Sperm cells with abnormally short flagella. Evidence: PCS. Frequency: 2/2. (PMID:29365104)